- Abnormality of the kidney (HP:0000077): An abnormality of the kidney. Evidence: IEA. (OMIM:163700)
- Supernumerary nipple (HP:0002558): Presence of more than two nipples. Evidence: IEA. (OMIM:163700)
- Autosomal dominant inheritance (HP:0000006): A mode of inheritance that is observed for traits related to a gene encoded on one of the autosomes (i.e., the human chromosomes 1-22) in which a trait manifests in heterozygotes. In the context of medical genetics, an autosomal dominant disorder is caused when a single copy of the mutant allele is present. Males and females are affected equally, and can both transmit the disorder with a risk of 50% for each child of inheriting the mutant allele. Evidence: IEA. (OMIM:163700)
- Abnormal thorax morphology (HP:0000765): Any abnormality of the thorax (the region of the body formed by the sternum, the thoracic vertebrae and the ribs). Evidence: IEA. (OMIM:163700)
These phenotypes are associated with the disease familial supernumerary nipples (OMIM:163700).